Phenotypes associated with the disease ocular cicatricial pemphigoid (OMIM:164185):
- Autosomal dominant inheritance (HP:0000006): A mode of inheritance that is observed for traits related to a gene encoded on one of the autosomes (i.e., the human chromosomes 1-22) in which a trait manifests in heterozygotes. In the context of medical genetics, an autosomal dominant disorder is caused when a single copy of the mutant allele is present. Males and females are affected equally, and can both transmit the disorder with a risk of 50% for each child of inheriting the mutant allele. Evidence: IEA. (OMIM:164185)
- Abnormality of the eye (HP:0000478): Any abnormality of the eye, including location, spacing, and intraocular abnormalities. Evidence: IEA. (OMIM:164185)